Phenotypes associated with the disease chronic mucocutaneous candidiasis due to lymphokine deficiency (OMIM:247650):
- Abnormality of metabolism/homeostasis (HP:0001939). Evidence: IEA. (OMIM:247650)
- Recurrent mucocutaneous candidiasis (HP:0002728): Recurrent or persistent superficial Candida infections of the skin, mucous membranes, and nails. Evidence: IEA. (OMIM:247650)
- Autosomal recessive inheritance (HP:0000007): A mode of inheritance that is observed for traits related to a gene encoded on one of the autosomes (i.e., the human chromosomes 1-22) in which a trait manifests in individuals with two pathogenic alleles, either homozygotes (two copies of the same mutant allele) or compound heterozygotes (whereby each copy of a gene has a distinct mutant allele). Evidence: IEA. (OMIM:247650)